- Cryptorchidism (HP:0000028): Testis in inguinal canal. That is, absence of one or both testes from the scrotum owing to failure of the testis or testes to descend through the inguinal canal to the scrotum. Evidence: TAS. Frequency: Frequent (HP:0040282). (ORPHA:363659)
- Bifid scrotum (HP:0000048): Midline indentation or cleft of the scrotum. Evidence: TAS. Frequency: Frequent (HP:0040282). (ORPHA:363659)
- Gingival overgrowth (HP:0000212): Hyperplasia of the gingiva (that is, a thickening of the soft tissue overlying the alveolar ridge. The degree of thickening ranges from involvement of the interdental papillae alone to gingival overgrowth covering the entire tooth crown. Evidence: TAS. Frequency: Frequent (HP:0040282). (ORPHA:363659)
- Microcephaly (HP:0000252): Head circumference below 2 standard deviations below the mean for age and gender. Evidence: TAS. Frequency: Frequent (HP:0040282). (ORPHA:363659)
- Retrognathia (HP:0000278): An abnormality in which the mandible is mislocalised posteriorly. Evidence: TAS. Frequency: Frequent (HP:0040282). (ORPHA:363659)
- Coarse facial features (HP:0000280): Absence of fine and sharp appearance of brows, nose, lips, mouth, and chin, usually because of rounded and heavy features or thickened skin with or without thickening of subcutaneous and bony tissues. Evidence: TAS. Frequency: Frequent (HP:0040282). (ORPHA:363659)
- Epicanthus (HP:0000286): A fold of skin starting above the medial aspect of the upper eyelid and arching downward to cover, pass in front of and lateral to the medial canthus. Evidence: TAS. Frequency: Frequent (HP:0040282). (ORPHA:363659)
- Full cheeks (HP:0000293): Increased prominence or roundness of soft tissues between zygomata and mandible. Evidence: TAS. Frequency: Frequent (HP:0040282). (ORPHA:363659)
- Posteriorly rotated ears (HP:0000358): A type of abnormal location of the ears in which the position of the ears is characterized by posterior rotation (the superior part of the ears is rotated towards the back of the head, and the inferior part of the ears towards the front). Evidence: TAS. Frequency: Frequent (HP:0040282). (ORPHA:363659)
- Wide nasal bridge (HP:0000431): Increased breadth of the nasal bridge (and with it, the nasal root). Evidence: TAS. Frequency: Frequent (HP:0040282). (ORPHA:363659)
- Proptosis (HP:0000520): An eye that is protruding anterior to the plane of the face to a greater extent than is typical. Evidence: TAS. Frequency: Frequent (HP:0040282). (ORPHA:363659)
- Delayed speech and language development (HP:0000750): A degree of language development that is significantly below the norm for a child of a specified age. Evidence: TAS. Frequency: Frequent (HP:0040282). (ORPHA:363659)
- Global developmental delay (HP:0001263): A delay in the achievement of motor or mental milestones in the domains of development of a child, including motor skills, speech and language, cognitive skills, and social and emotional skills. This term should only be used to describe children younger than five years of age. Evidence: TAS. Frequency: Frequent (HP:0040282). (ORPHA:363659)
- Growth delay (HP:0001510): A deficiency or slowing down of growth pre- and postnatally. Evidence: TAS. Frequency: Frequent (HP:0040282). (ORPHA:363659)
- Short foot (HP:0001773): A measured foot length that is more than 2 SD below the mean for a newborn of 27 - 41 weeks gestation, or foot that is less than the 3rd centile for individuals from birth to 16 years of age (objective). Alternatively, a foot that appears disproportionately short (subjective). Evidence: TAS. Frequency: Frequent (HP:0040282). (ORPHA:363659)
- Moderate intellectual disability (HP:0002342): Moderate intellectual disability (ID) is defined as a type of ID characterized by moderately sub-average adaptive functioning and intellectual functioning, with an intelligence quotient (IQ) the range of 35-49. Evidence: TAS. Frequency: Frequent (HP:0040282). (ORPHA:363659)
- Short nose (HP:0003196): Distance from nasion to subnasale more than two standard deviations below the mean, or alternatively, an apparently decreased length from the nasal root to the nasal tip. Evidence: TAS. Frequency: Frequent (HP:0040282). (ORPHA:363659)
- Short palm (HP:0004279): Short palm. Evidence: TAS. Frequency: Frequent (HP:0040282). (ORPHA:363659)
- Depressed nasal bridge (HP:0005280): Posterior positioning of the nasal root in relation to the overall facial profile for age. Evidence: TAS. Frequency: Frequent (HP:0040282). (ORPHA:363659)
- Prominent metopic ridge (HP:0005487): Vertical bony ridge positioned in the midline of the forehead. Evidence: TAS. Frequency: Frequent (HP:0040282). (ORPHA:363659)
- Microtia (HP:0008551): Underdevelopment of the external ear. Evidence: TAS. Frequency: Frequent (HP:0040282). (ORPHA:363659)
- Underdeveloped supraorbital ridges (HP:0009891): Flatness of the supraorbital portion of the frontal bones. Evidence: TAS. Frequency: Frequent (HP:0040282). (ORPHA:363659)
- Tented upper lip vermilion (HP:0010804): Triangular appearance of the oral aperture with the apex in the midpoint of the upper vermilion and the lower vermilion forming the base. Evidence: TAS. Frequency: Frequent (HP:0040282). (ORPHA:363659)
- High myopia (HP:0011003): A severe form of myopia with greater than -6.00 diopters. Evidence: TAS. Frequency: Frequent (HP:0040282). (ORPHA:363659)
- Tented philtrum (HP:0011825): Prominence of a triangular soft tissue area of the philtrum with the apex to the columella. Evidence: TAS. Frequency: Frequent (HP:0040282). (ORPHA:363659)
- Flat face (HP:0012368): Absence of concavity or convexity of the face when viewed in profile. Evidence: TAS. Frequency: Frequent (HP:0040282). (ORPHA:363659)
- Periorbital edema (HP:0100539): Edema affecting the region situated around the orbit of the eye. Evidence: TAS. Frequency: Frequent (HP:0040282). (ORPHA:363659)
- Palpebral edema (HP:0100540): Edema in the region of the eyelids. Evidence: TAS. Frequency: Frequent (HP:0040282). (ORPHA:363659)
- Inguinal hernia (HP:0000023): Protrusion of the contents of the abdominal cavity through the inguinal canal. Evidence: TAS. Frequency: Occasional (HP:0040283). (ORPHA:363659)
- Micropenis (HP:0000054): Abnormally small penis. At birth, the normal penis is about 3 cm (stretched length from pubic tubercle to tip of penis) with micropenis less than 2.0-2.5 cm. Evidence: TAS. Frequency: Occasional (HP:0040283). (ORPHA:363659)
- Abnormal oral frenulum morphology (HP:0000190): An abnormality of the lingual frenulum, that is of the small fold of mucous membrane that attaches the tongue to the floor of the mouth, or the presence of accessory frenula in the oral cavity. Evidence: TAS. Frequency: Occasional (HP:0040283). (ORPHA:363659)
- Trigonocephaly (HP:0000243): Wedge-shaped, or triangular head, with the apex of the triangle at the midline of the forehead and the base of the triangle at the occiput. Evidence: TAS. Frequency: Occasional (HP:0040283). (ORPHA:363659)
- Brachycephaly (HP:0000248): An abnormality of skull shape characterized by a decreased anterior-posterior diameter. That is, a cephalic index greater than 81%. Alternatively, an apparently shortened anteroposterior dimension (length) of the head compared to width. Evidence: TAS. Frequency: Occasional (HP:0040283). (ORPHA:363659)
- Triangular face (HP:0000325): Facial contour, as viewed from the front, triangular in shape, with breadth at the temples and tapering to a narrow chin. Evidence: TAS. Frequency: Occasional (HP:0040283). (ORPHA:363659)
- Narrow forehead (HP:0000341): Width of the forehead or distance between the frontotemporales is more than two standard deviations below the mean (objective); or apparently narrow intertemporal region (subjective). Evidence: TAS. Frequency: Occasional (HP:0040283). (ORPHA:363659)
- Abnormal nasal bridge morphology (HP:0000422): Abnormality of the nasal bridge, which is the saddle-shaped area that includes the nasal root and the lateral aspects of the nose. It lies between the glabella and the inferior boundary of the nasal bone, and extends laterally to the inner canthi. Evidence: TAS. Frequency: Occasional (HP:0040283). (ORPHA:363659)
- Anteverted nares (HP:0000463): Anteriorly-facing nostrils viewed with the head in the Frankfurt horizontal and the eyes of the observer level with the eyes of the subject. This gives the appearance of an upturned nose (upturned nasal tip). Evidence: TAS. Frequency: Occasional (HP:0040283). (ORPHA:363659)
- Downslanted palpebral fissures (HP:0000494): The palpebral fissure inclination is more than two standard deviations below the mean. Evidence: TAS. Frequency: Occasional (HP:0040283). (ORPHA:363659)
- Ptosis (HP:0000508): The upper eyelid margin is positioned 3 mm or more lower than usual and covers the superior portion of the iris (objective); or, the upper lid margin obscures at least part of the pupil (subjective). Evidence: TAS. Frequency: Occasional (HP:0040283). (ORPHA:363659)
- Nystagmus (HP:0000639): Rhythmic, involuntary oscillations of one or both eyes related to abnormality in fixation, conjugate gaze, or vestibular mechanisms. Evidence: TAS. Frequency: Occasional (HP:0040283). (ORPHA:363659)
- Short attention span (HP:0000736): Reduced attention span characterized by distractibility and impulsivity. Evidence: TAS. Frequency: Occasional (HP:0040283). (ORPHA:363659)
- Pectus excavatum (HP:0000767): A defect of the chest wall characterized by a depression of the sternum, giving the chest ("pectus") a caved-in ("excavatum") appearance. Evidence: TAS. Frequency: Occasional (HP:0040283). (ORPHA:363659)
- Pectus carinatum (HP:0000768): A deformity of the chest caused by overgrowth of the ribs and characterized by protrusion of the sternum. Evidence: TAS. Frequency: Occasional (HP:0040283). (ORPHA:363659)
- Sacral dimple (HP:0000960): A cutaneous indentation resulting from tethering of the skin to underlying structures (bone) of the intergluteal cleft. Evidence: TAS. Frequency: Occasional (HP:0040283). (ORPHA:363659)
- Seizure (HP:0001250): A seizure is an intermittent abnormality of nervous system physiology characterized by a transient occurrence of signs and/or symptoms due to abnormal excessive or synchronous neuronal activity in the brain. Evidence: TAS. Frequency: Occasional (HP:0040283). (ORPHA:363659)
- Limited elbow extension (HP:0001377): Limited ability to straighten the arm at the elbow joint. Evidence: TAS. Frequency: Occasional (HP:0040283). (ORPHA:363659)
- Clinodactyly of the 5th finger (HP:0004209): Clinodactyly refers to a bending or curvature of the fifth finger in the radial direction (i.e., towards the 4th finger). Evidence: TAS. Frequency: Occasional (HP:0040283). (ORPHA:363659)
- Deep palmar crease (HP:0006191): Excessively deep creases of the palm. Evidence: TAS. Frequency: Occasional (HP:0040283). (ORPHA:363659)
- Severe intrauterine growth retardation (HP:0008846): Intrauterine growth retardation that is 4 or more standard deviations below average, corrected for sex and gestational age. Evidence: TAS. Frequency: Occasional (HP:0040283). (ORPHA:363659)
- Thickened ears (HP:0009894): Increased thickness of the external ear. Evidence: TAS. Frequency: Occasional (HP:0040283). (ORPHA:363659)
- Severe intellectual disability (HP:0010864): Severe intellectual disability (ID) is defined as a type of ID characterized by severely sub-average adaptive functioning and intellectual functioning, with an intelligence quotient (IQ) the range of 20-34. Evidence: TAS. Frequency: Occasional (HP:0040283). (ORPHA:363659)
- Lingual dystonia (HP:0031008): Involuntary protrusions, movements, spams and contortions of the tongue. Evidence: TAS. Frequency: Occasional (HP:0040283). (ORPHA:363659)
- Abnormal shape of the palpebral fissure (HP:0200005): The presence of an abnormal shape of the palpebral fissure. Evidence: TAS. Frequency: Occasional (HP:0040283). (ORPHA:363659)
These phenotypes are associated with the disease 20q11.2 microduplication syndrome (ORPHA:363659).